- Spicular pigmentation of the retina (HP:0007737): Pigment migration into the retina in a bone-spicule configuration (resembling the nucleated cells within the lacuna of bone). Evidence: PCS. (PMID:20797688)
- Juvenile onset (HP:0003621): Onset of signs or symptoms of disease between the age of 5 and 15 years. Evidence: PCS. Frequency: 4/4. (PMID:20797688)
- Nyctalopia (HP:0000662): Inability to see well at night or in poor light. Evidence: PCS. Frequency: 4/4. Onset: Juvenile onset (HP:0003621). (PMID:20797688)
- Macular degeneration (HP:0000608): A nonspecific term denoting degeneration of the retinal pigment epithelium and/or retinal photoreceptor cells of the macula lutea. Evidence: PCS. Frequency: 4/4. (PMID:20797688)
- Severely reduced visual acuity (HP:0001141): Severe reduction of the ability to see. On the 6m visual acuity scale, severe reduction is defined as less than 6/60 but at least 3/60. On the 20ft visual acuity scale, severe reduction is defined as less than 20/200 but at least 20/400. On the decimal visual acuity scale, severe reduction is defined as less than 0.1 but at least 0.05. Evidence: PCS. Frequency: 4/4. (PMID:20797688)
- Abnormal light- and dark-adapted electroretinogram (HP:0008323): An abnormality of the combined rod-and-cone response on electroretinogram. Evidence: PCS. Frequency: 4/4. (PMID:20797688)
- Autosomal recessive inheritance (HP:0000007): A mode of inheritance that is observed for traits related to a gene encoded on one of the autosomes (i.e., the human chromosomes 1-22) in which a trait manifests in individuals with two pathogenic alleles, either homozygotes (two copies of the same mutant allele) or compound heterozygotes (whereby each copy of a gene has a distinct mutant allele). Evidence: PCS. (PMID:20797688)
- Peripheral visual field loss (HP:0007994): Loss of peripheral vision with retention of central vision, resulting in a constricted circular tunnel-like field of vision. Evidence: PCS. Frequency: 4/4. (PMID:20797688)
- Optic disc pallor (HP:0000543): A pale yellow discoloration of the optic disc (the area of the optic nerve head in the retina). The optic disc normally has a pinkish hue with a central yellowish depression. Evidence: PCS. Frequency: 4/4. (PMID:20797688)
- Rod-cone dystrophy (HP:0000510): An inherited retinal disease subtype in which the rod photoreceptors appear to be more severely affected than the cone photoreceptors. Typical presentation is with nyctalopia (due to rod dysfunction) followed by loss of mid-peripheral field of vision, which gradually extends and leaves many patients with a small central island of vision due to the preservation of macular cones. Evidence: PCS. (PMID:20797688)
- Attenuation of retinal blood vessels (HP:0007843): Narrowing of the retinal blood vessels, both arterioles and venules. Evidence: PCS. Frequency: 4/4. (PMID:20797688)
These phenotypes are associated with the disease retinitis pigmentosa 58 (OMIM:613617).